Phenotypes associated with the disease chromosome 1p36 deletion syndrome, proximal (OMIM:619343):
- Parietal bossing (HP:0000242): Parietal bossing is a marked prominence in the parietal region. Evidence: PCS. Frequency: 3/5. (PMID:17850629)
- Epicanthus (HP:0000286): A fold of skin starting above the medial aspect of the upper eyelid and arching downward to cover, pass in front of and lateral to the medial canthus. Evidence: PCS. Frequency: 4/5. (PMID:17850629)
- Complete atrioventricular canal defect (HP:0001674): A congenital heart defect characterized by a specific combination of heart defects with a common atrioventricular valve, primum atrial septal defect and inlet ventricular septal defect. Evidence: PCS. Frequency: 1/5. (PMID:17850629)
- Anteverted nares (HP:0000463): Anteriorly-facing nostrils viewed with the head in the Frankfurt horizontal and the eyes of the observer level with the eyes of the subject. This gives the appearance of an upturned nose (upturned nasal tip). Evidence: PCS. Frequency: 5/5. (PMID:17850629)
- Seizure (HP:0001250): A seizure is an intermittent abnormality of nervous system physiology characterized by a transient occurrence of signs and/or symptoms due to abnormal excessive or synchronous neuronal activity in the brain. Evidence: PCS. Frequency: 3/5. (PMID:17850629)
- Hypotonia (HP:0001252): Hypotonia is an abnormally low muscle tone (the amount of tension or resistance to movement in a muscle). Even when relaxed, muscles have a continuous and passive partial contraction which provides some resistance to passive stretching. Hypotonia thus manifests as diminished resistance to passive stretching. Hypotonia is not the same as muscle weakness, although the two conditions can co-exist. Evidence: PCS. Frequency: 5/5. (PMID:17850629)
- Infantile onset (HP:0003593): Onset of signs or symptoms of disease between 28 days to one year of life. Evidence: PCS. Frequency: 1/5. (PMID:17850629)
- Cleft lip (HP:0410030): A gap in the lip or lips. Evidence: PCS. Frequency: 1/5. (PMID:17850629)
- Ventricular septal defect (HP:0001629): A hole between the two bottom chambers (ventricles) of the heart. The defect is centered around the most superior aspect of the ventricular septum. Evidence: PCS. Frequency: 2/5. (PMID:17850629)
- Failure to thrive (HP:0001508): Failure to thrive (FTT) refers to a child whose physical growth is substantially below the norm. Evidence: PCS. Frequency: 5/5. (PMID:17850629)
- Fetal onset (HP:0011461): Onset prior to birth but after 8 weeks of embryonic development (corresponding to a gestational age of 10 weeks). Evidence: PCS. Frequency: 2/5. (PMID:17850629)
- Bicuspid aortic valve (HP:0001647): The presence of an aortic valve with two instead of the normal three cusps (flaps). Bicuspid aortic valvue is a malformation of a commissure (small space between the attachment of each cusp to the aortic wall) and the adjacent parts of the two corresponding cusps forming a raphe (the fused area of the two underdeveloped cusps turning into a malformed commissure between both cusps; the raphe is a fibrous ridge that extends from the commissure to the free edge of the two underdeveloped, conjoint cusps). Evidence: PCS. Frequency: 1/5. (PMID:17850629)
- High palate (HP:0000218): Height of the palate more than 2 SD above the mean (objective) or palatal height at the level of the first permanent molar more than twice the height of the teeth (subjective). Evidence: PCS. Frequency: 1/4. (PMID:17850629)
- Clinodactyly (HP:0030084): An angulation of a digit at an interphalangeal joint in the plane of the palm (finger) or sole (toe). Evidence: PCS. Frequency: 3/5. (PMID:17850629)
- Patent ductus arteriosus (HP:0001643): In utero, the ductus arteriosus (DA) serves to divert ventricular output away from the lungs and toward the placenta by connecting the main pulmonary artery to the descending aorta. A patent ductus arteriosus (PDA) in the first 3 days of life is a physiologic shunt in healthy term and preterm newborn infants, and normally is substantially closed within about 24 hours after bith and completely closed after about three weeks. Failure of physiologcal closure is referred to a persistent or patent ductus arteriosus (PDA). Depending on the degree of left-to-right shunting, PDA can have clinical consequences. Evidence: PCS. Frequency: 2/5. (PMID:17850629)
- Pulmonic stenosis (HP:0001642): A narrowing of the right ventricular outflow tract that can occur at the pulmonary valve (valvular stenosis), below the pulmonary valve (infundibular stenosis), or above the pulmonary valve (supravalvar stenosis). Evidence: PCS. Frequency: 1/5. (PMID:17850629)
- Contiguous gene syndrome (HP:0001466): A syndrome caused by the effects of abnormality (typically a deletion or duplication) of 2 or more adjacent genes. Evidence: PCS. (PMID:17850629)
- Posteriorly rotated ears (HP:0000358): A type of abnormal location of the ears in which the position of the ears is characterized by posterior rotation (the superior part of the ears is rotated towards the back of the head, and the inferior part of the ears towards the front). Evidence: PCS. Frequency: 5/5. (PMID:17850629)
- Hirsutism (HP:0001007): Abnormally increased hair growth referring to a male pattern of body hair (androgenic hair). Evidence: PCS. Frequency: 4/5. (PMID:17850629)
- Bifid nasal tip (HP:0000456): A splitting of the nasal tip. Visually assessable vertical indentation, cleft, or depression of the nasal tip. Evidence: PCS. Frequency: 1/5. (PMID:17850629)
- Dilated cardiomyopathy (HP:0001644): Dilated cardiomyopathy (DCM) is defined by the presence of left ventricular dilatation and left ventricular systolic dysfunction in the absence of abnormal loading conditions (hypertension, valve disease) or coronary artery disease sufficient to cause global systolic impairment. Right ventricular dilation and dysfunction may be present but are not necessary for the diagnosis. Evidence: PCS. Frequency: 1/5. (PMID:17850629)
- Neonatal onset (HP:0003623): Onset of signs or symptoms of disease within the first 28 days of life. Evidence: PCS. Frequency: 2/5. (PMID:17850629)
- Microcephaly (HP:0000252): Head circumference below 2 standard deviations below the mean for age and gender. Evidence: PCS. Frequency: 4/5. (PMID:17850629)
- Cleft palate (HP:0000175): Cleft palate is a developmental defect of the palate resulting from a failure of fusion of the palatine processes and manifesting as a separation of the roof of the mouth (soft and hard palate). Evidence: PCS. Frequency: 1/5. (PMID:17850629)
- Delayed speech and language development (HP:0000750): A degree of language development that is significantly below the norm for a child of a specified age. Evidence: PCS. Frequency: 3/3. (PMID:17850629)
- Biventricular hypertrophy (HP:0200128): Thickening of the heart walls in both ventricles. Evidence: PCS. Frequency: 1/5. (PMID:17850629)
- Global developmental delay (HP:0001263): A delay in the achievement of motor or mental milestones in the domains of development of a child, including motor skills, speech and language, cognitive skills, and social and emotional skills. This term should only be used to describe children younger than five years of age. Evidence: PCS. Frequency: 5/5. (PMID:17850629)
- Midface retrusion (HP:0011800): Posterior positions and/or vertical shortening of the infraorbital and perialar regions, or increased concavity of the face and/or reduced nasolabial angle. Evidence: PCS. Frequency: 3/5. (PMID:17850629)
- Partial anomalous pulmonary venous return (HP:0010773): A form of anomalous pulmonary venous return in which not all pulmonary veins drain abnormally. Partial anomalous pulmonary venous return frequently involves one or both of the veins from one lung. Evidence: PCS. Frequency: 1/5. (PMID:17850629)
- Coronary artery fistula (HP:0011641): A congenital malformation with abnormal connection between one of the coronary arteries and a heart chamber or another blood vessel. Evidence: PCS. Frequency: 1/5. (PMID:17850629)
- Broad eyebrow (HP:0011229): Regional increase in the width (height) of the eyebrow. Evidence: PCS. Frequency: 4/5. (PMID:17850629)
- Camptodactyly (HP:0012385): The distal interphalangeal joint and/or the proximal interphalangeal joint of the fingers or toes cannot be extended to 180 degrees by either active or passive extension. Evidence: PCS. Frequency: 2/5. (PMID:17850629)
- Wolff-Parkinson-White syndrome (HP:0001716): A disorder of the cardiac conduction system of the heart characterized by ventricular preexcitation due to the presence of an abnormal accessory atrioventricular electrical conduction pathway. Evidence: PCS. Frequency: 1/5. (PMID:17850629)
- Pointed chin (HP:0000307): A marked tapering of the lower face to the chin. Evidence: PCS. Frequency: 3/5. (PMID:17850629)
- Frontal bossing (HP:0002007): Bilateral bulging of the lateral frontal bone prominences with relative sparing of the midline. Evidence: PCS. Frequency: 3/5. (PMID:17850629)
- Atrial septal defect (HP:0001631): Atrial septal defect (ASD) is a congenital abnormality of the interatrial septum that enables blood flow between the left and right atria via the interatrial septum. Evidence: PCS. Frequency: 1/5. (PMID:17850629)
- Low-set ears (HP:0000369): Upper insertion of the ear to the scalp below an imaginary horizontal line drawn between the inner canthi of the eye and extending posteriorly to the ear. Evidence: PCS. Frequency: 5/5. (PMID:17850629)
- Micrognathia (HP:0000347): Developmental hypoplasia of the mandible. Evidence: PCS. Frequency: 3/5. (PMID:17850629)
- Autosomal dominant inheritance (HP:0000006): A mode of inheritance that is observed for traits related to a gene encoded on one of the autosomes (i.e., the human chromosomes 1-22) in which a trait manifests in heterozygotes. In the context of medical genetics, an autosomal dominant disorder is caused when a single copy of the mutant allele is present. Males and females are affected equally, and can both transmit the disorder with a risk of 50% for each child of inheriting the mutant allele. Evidence: PCS. (PMID:17850629)
- Patent foramen ovale (HP:0001655): Failure of the foramen ovale to seal postnatally, leaving a potential conduit between the left and right cardiac atria. Evidence: PCS. Frequency: 1/5. (PMID:17850629)